Phenotypes associated with the disease Wolf-Hirschhorn syndrome (DECIPHER:1):
- Microcephaly (HP:0000252): Head circumference below 2 standard deviations below the mean for age and gender. Evidence: IEA. (DECIPHER:1)
- Seizure (HP:0001250): A seizure is an intermittent abnormality of nervous system physiology characterized by a transient occurrence of signs and/or symptoms due to abnormal excessive or synchronous neuronal activity in the brain. Evidence: IEA. (DECIPHER:1)
- Small for gestational age (HP:0001518): Smaller than normal size according to sex and gestational age related norms, defined as a weight below the 10th percentile for the gestational age. Evidence: IEA. (DECIPHER:1)
- Hypotonia (HP:0001252): Hypotonia is an abnormally low muscle tone (the amount of tension or resistance to movement in a muscle). Even when relaxed, muscles have a continuous and passive partial contraction which provides some resistance to passive stretching. Hypotonia thus manifests as diminished resistance to passive stretching. Hypotonia is not the same as muscle weakness, although the two conditions can co-exist. Evidence: IEA. (DECIPHER:1)
- Intellectual disability (HP:0001249): The term intellectual disability or intellectual developmental disorder is used to describe significantly sub-average intellectual and adaptive functioning based on clinical assessment and as measured by individually administered, appropriately normed, standardized and validated tests of intellectual functioning and adaptive behavior, with onset during the developmental period from infancy through adolescence. Evidence: IEA. (DECIPHER:1)